Phenotypes associated with the disease Classic multiminicore myopathy (ORPHA:324604):
- Muscular dystrophy (HP:0003560): The term dystrophy means abnormal growth. However, muscular dystrophy is used to describe primary myopathies with a genetic basis and a progressive course characterized by progressive skeletal muscle weakness and wasting, defects in muscle proteins, and histological features of muscle fiber degeneration (necrosis) and regeneration. If possible, it is preferred to use other HPO terms to describe the precise phenotypic abnormalities. Evidence: TAS. Frequency: Very frequent (HP:0040281). (ORPHA:324604)
- High palate (HP:0000218): Height of the palate more than 2 SD above the mean (objective) or palatal height at the level of the first permanent molar more than twice the height of the teeth (subjective). Evidence: TAS. Frequency: Frequent (HP:0040282). (ORPHA:324604)
- Generalized hypotonia (HP:0001290): Generalized muscular hypotonia (abnormally low muscle tone). Evidence: TAS. Frequency: Frequent (HP:0040282). (ORPHA:324604)
- Failure to thrive (HP:0001508): Failure to thrive (FTT) refers to a child whose physical growth is substantially below the norm. Evidence: TAS. Frequency: Frequent (HP:0040282). (ORPHA:324604)
- Abnormally high-pitched voice (HP:0001620): A persistent (minutes to hours) abnormal increase in the pitch (frequency) of the voice for the context or social situation or significantly different from baseline of the individual. Evidence: TAS. Frequency: Frequent (HP:0040282). (ORPHA:324604)
- Restrictive ventilatory defect (HP:0002091): A functional defect characterized by reduced total lung capacity (TLC) not associated with abnormalities of expiratory airflow or airway resistance. Spirometrically, a restrictive defect is defined as FEV1 (forced expiratory volume in 1 second) and FVC (forced vital capacity) less than 80 per cent. Restrictive lung disease may be caused by alterations in lung parenchyma or because of a disease of the pleura, chest wall, or neuromuscular apparatus. Evidence: TAS. Frequency: Frequent (HP:0040282). (ORPHA:324604)
- Delayed gross motor development (HP:0002194): A type of motor delay characterized by a delay in acquiring the ability to control the large muscles of the body for walking, running, sitting, and crawling. Evidence: TAS. Frequency: Frequent (HP:0040282). (ORPHA:324604)
- Poor head control (HP:0002421): Difficulty to maintain correct position of the head while standing or sitting. Infant head lag is observed when the head seems to flop around or lags posteriorly behind the trunk. Several articles have maintained that head lag should be absent by age 3 to 4 months. Evidence: TAS. Frequency: Frequent (HP:0040282). (ORPHA:324604)
- Scoliosis (HP:0002650): The presence of an abnormal lateral curvature of the spine. Evidence: TAS. Frequency: Frequent (HP:0040282). (ORPHA:324604)
- Multiple joint contractures (HP:0002828). Evidence: TAS. Frequency: Frequent (HP:0040282). (ORPHA:324604)
- Nocturnal hypoventilation (HP:0002877): An abnormal reduction in alveolar ventilation occurring during sleep. This is characterized by a rise in arterial carbon dioxide. Evidence: TAS. Frequency: Frequent (HP:0040282). (ORPHA:324604)
- Spinal rigidity (HP:0003306): Reduced ability to move the vertebral column with a resulting limitation of neck and trunk flexion. Evidence: TAS. Frequency: Frequent (HP:0040282). (ORPHA:324604)
- Axial muscle weakness (HP:0003327): Reduced strength of the axial musculature (i.e., of the muscles of the head and neck, spine, and ribs). Evidence: TAS. Frequency: Frequent (HP:0040282). (ORPHA:324604)
- Generalized amyotrophy (HP:0003700): Generalized (diffuse, unlocalized) amyotrophy (muscle atrophy) affecting multiple muscles. Evidence: TAS. Frequency: Frequent (HP:0040282). (ORPHA:324604)
- Short stature (HP:0004322): A height below that which is expected according to age and gender norms. Although there is no universally accepted definition of short stature, many refer to "short stature" as height more than 2 standard deviations below the mean for age and gender (or below the 3rd percentile for age and gender dependent norms). Evidence: TAS. Frequency: Frequent (HP:0040282). (ORPHA:324604)
- Intermittent episodes of respiratory insufficiency due to muscle weakness (HP:0004889). Evidence: TAS. Frequency: Frequent (HP:0040282). (ORPHA:324604)
- Limited neck flexion (HP:0005991): Reduced ability to lower the chin towards the chest by bending the neck. Evidence: TAS. Frequency: Frequent (HP:0040282). (ORPHA:324604)
- Increased muscle lipid content (HP:0009058): An abnormal accumulation of lipids in skeletal muscle. Evidence: TAS. Frequency: Frequent (HP:0040282). (ORPHA:324604)
- Weakness of facial musculature (HP:0030319): Reduced strength of one or more muscles innervated by the facial nerve (the seventh cranial nerve). Evidence: TAS. Frequency: Frequent (HP:0040282). (ORPHA:324604)
- Muscle fiber atrophy (HP:0100295). Evidence: TAS. Frequency: Frequent (HP:0040282). (ORPHA:324604)
- Mandibular prognathia (HP:0000303): Abnormal prominence of the chin related to increased length of the mandible. Evidence: TAS. Frequency: Occasional (HP:0040283). (ORPHA:324604)
- Microretrognathia (HP:0000308): A form of developmental hypoplasia of the mandible in which the mandible is mislocalised posteriorly. Evidence: TAS. Frequency: Occasional (HP:0040283). (ORPHA:324604)
- Hip dysplasia (HP:0001385): The presence of developmental dysplasia of the hip. Evidence: TAS. Frequency: Occasional (HP:0040283). (ORPHA:324604)
- Mitral valve prolapse (HP:0001634): One or both of the leaflets (cusps) of the mitral valve bulges back into the left atrium upon contraction of the left ventricle. Evidence: TAS. Frequency: Occasional (HP:0040283). (ORPHA:324604)
- Congestive heart failure (HP:0001635): The presence of an abnormality of cardiac function that is responsible for the failure of the heart to pump blood at a rate that is commensurate with the needs of the tissues or a state in which abnormally elevated filling pressures are required for the heart to do so. Heart failure is frequently related to a defect in myocardial contraction. Evidence: TAS. Frequency: Occasional (HP:0040283). (ORPHA:324604)
- Right ventricular hypertrophy (HP:0001667): In this case the right ventricle is more muscular than normal, causing a characteristic boot-shaped (coeur-en-sabot) appearance as seen on anterior- posterior chest x-rays. Right ventricular hypertrophy is commonly associated with any form of right ventricular outflow obstruction or pulmonary hypertension, which may in turn owe its origin to left-sided disease. The echocardiographic signs are thickening of the anterior right ventricular wall and the septum. Cavity size is usually normal, or slightly enlarged. In many cases there is associated volume overload present due to tricuspid regurgitation, in the absence of this, septal motion is normal. Evidence: TAS. Frequency: Occasional (HP:0040283). (ORPHA:324604)
- Right ventricular failure (HP:0001708): Reduced ability of the right ventricle to perform its function (to receive blood from the right atrium and to eject blood into the pulmonary artery), often leading to pitting peripheral edema, ascites, and hepatomegaly. Evidence: TAS. Frequency: Occasional (HP:0040283). (ORPHA:324604)
- Pes planus (HP:0001763): A foot where the longitudinal arch of the foot is in contact with the ground or floor when the individual is standing; or, in a patient lying supine, a foot where the arch is in contact with the surface of a flat board pressed against the sole of the foot by the examiner with a pressure similar to that expected from weight bearing; or, the height of the arch is reduced. Evidence: TAS. Frequency: Occasional (HP:0040283). (ORPHA:324604)
Not associated with this disease:
- Absent muscle fiber merosin (HP:0030091): Lack of merosin protein in the muscle biopsy. Evidence: TAS. (ORPHA:324604)